Phenotypes associated with the disease dystonia 22, juvenile-onset (OMIM:620453):
- Torticollis (HP:0000473): Involuntary contractions of the neck musculature resulting in an abnormal posture of or abnormal movements of the head. Evidence: PCS. Frequency: 3/3. (PMID:33539324)
- Bilateral tonic-clonic seizure (HP:0002069): A bilateral tonic-clonic seizure is a seizure defined by a tonic (bilateral increased tone, lasting seconds to minutes) and then a clonic (bilateral sustained rhythmic jerking) phase. Evidence: PCS. Frequency: 1/3. (PMID:33539324)
- Juvenile onset (HP:0003621): Onset of signs or symptoms of disease between the age of 5 and 15 years. Evidence: PCS. Frequency: 3/3. (PMID:33539324)
- Hypometric saccades (HP:0000571): Saccadic undershoot, i.e., a saccadic eye movement that has less than the magnitude that would be required to gain fixation of the object. Evidence: PCS. Frequency: 2/3. (PMID:33539324)
- Dysmetria (HP:0001310): A type of ataxia characterized by the inability to carry out movements with the correct range and motion across the plane of more than one joint related to incorrect estimation of the distances required for targeted movements. Evidence: PCS. Frequency: 1/3. (PMID:33539324)
- Cerebellar atrophy (HP:0001272): Cerebellar atrophy is defined as a cerebellum with initially normal structures, in a posterior fossa with normal size, which displays enlarged fissures (interfolial spaces) in comparison to the foliae secondary to loss of tissue. Cerebellar atrophy implies irreversible loss of tissue and result from an ongoing progressive disease until a final stage is reached or a single injury, e.g. an intoxication or infectious event. Evidence: PCS. Frequency: 3/3. (PMID:33539324)
- Dysarthria (HP:0001260): Dysarthric speech is a general description referring to a neurological speech disorder characterized by poor articulation. Depending on the involved neurological structures, dysarthria may be further classified as spastic, flaccid, ataxic, hyperkinetic and hypokinetic, or mixed. Evidence: PCS. Frequency: 3/3. (PMID:33539324)
- Dysdiadochokinesis (HP:0002075): A type of ataxia characterized by the impairment of the ability to perform rapidly alternating movements, such as pronating and supinating his or her hand on the dorsum of the other hand as rapidly as possible. Evidence: PCS. Frequency: 1/3. (PMID:33539324)
- Lower limb spasticity (HP:0002061): Spasticity (velocity-dependent increase in tonic stretch reflexes with increased muscle tone and hyperexcitable tendon reflexes) in the muscles of the lower limbs, hips, and pelvis. Evidence: PCS. Frequency: 1/3. (PMID:33539324)
- Oromandibular dystonia (HP:0012048): A kind of focal dystonia characterized by forceful contractions of the face, jaw, and/or tongue causing difficulty in opening and closing the mouth and often affecting chewing and speech. Evidence: PCS. Frequency: 3/3. (PMID:33539324)
- Laryngeal dystonia (HP:0012049): A form of focal dystonia that affects the vocal cords, associated with involuntary contractions of the vocal cords causing interruptions of speech and affecting the voice quality and often leading to patterned, repeated breaks in speech. Evidence: PCS. Frequency: 3/3. (PMID:33539324)
- Intention tremor (HP:0002080): A type of kinetic tremor that occurs during target directed movement is called intention tremor. That is, an oscillatory cerebellar ataxia that tends to be absent when the limbs are inactive and during the first part of voluntary movement but worsening as the movement continues and greater precision is required (e.g., in touching a target such as the patient's nose or a physician's finger). Evidence: PCS. Frequency: 1/3. (PMID:33539324)
- Slow saccadic eye movements (HP:0000514): An abnormally slow velocity of the saccadic eye movements. Evidence: PCS. Frequency: 2/3. (PMID:33539324)
- Autosomal recessive inheritance (HP:0000007): A mode of inheritance that is observed for traits related to a gene encoded on one of the autosomes (i.e., the human chromosomes 1-22) in which a trait manifests in individuals with two pathogenic alleles, either homozygotes (two copies of the same mutant allele) or compound heterozygotes (whereby each copy of a gene has a distinct mutant allele). Evidence: PCS. (PMID:33539324)
- Generalized dystonia (HP:0007325): A type of dystonia that affects all or most of the body. Evidence: PCS. Frequency: 3/3. (PMID:33539324)
- Mental deterioration (HP:0001268): Loss of previously present mental abilities, generally in adults. Evidence: PCS. Frequency: 3/3. Onset: Adult onset (HP:0003581). (PMID:33539324)